- Amyotrophic lateral sclerosis (HP:0007354). Evidence: TAS. Frequency: Obligate (HP:0040280). (ORPHA:803)
- Neurodegeneration (HP:0002180): Progressive loss of neural cells and tissue. Evidence: TAS. Frequency: Very frequent (HP:0040281). (ORPHA:803)
- Generalized muscle weakness (HP:0003324): Generalized weakness or decreased strength of the muscles, affecting both distal and proximal musculature. Evidence: TAS. Frequency: Very frequent (HP:0040281). (ORPHA:803)
- Motor neuron atrophy (HP:0007373): Wasting involving the motor neuron. Evidence: TAS. Frequency: Very frequent (HP:0040281). (ORPHA:803)
- Xerostomia (HP:0000217): Dryness of the mouth due to salivary gland dysfunction. Evidence: TAS. Frequency: Frequent (HP:0040282). (ORPHA:803)
- Atypical behavior (HP:0000708): Atypical behavior is an abnormality in a person's actions that can be controlled or modulated by the will of the individual. While abnormal behaviors can be difficult to control, they are distinct from other abnormal actions that cannot be affected by the individual's will. Evidence: TAS. Frequency: Frequent (HP:0040282). (ORPHA:803)
- Emotional lability (HP:0000712): Unstable emotional experiences and frequent mood changes; emotions that are easily aroused, intense, and/or disproportionate to events and circumstances. Evidence: TAS. Frequency: Frequent (HP:0040282). (ORPHA:803)
- Depression (HP:0000716): Frequently experiencing feelings of being down, miserable, and/or hopeless; struggling to recover from these moods; having a pessimistic outlook on the future; feeling a pervasive sense of shame; having a low self-worth; experiencing thoughts of suicide and engaging in suicidal behavior. Evidence: TAS. Frequency: Frequent (HP:0040282). (ORPHA:803)
- Anxiety (HP:0000739): Intense feelings of nervousness, tension, or panic often arise in response to interpersonal stresses. There is worry about the negative effects of past unpleasant experiences and future negative possibilities. Individuals may feel fearful, apprehensive, or threatened by uncertainty, and they may also have fears of falling apart or losing control. Evidence: TAS. Frequency: Frequent (HP:0040282). (ORPHA:803)
- Spasticity (HP:0001257): A motor disorder characterized by a velocity-dependent increase in tonic stretch reflexes with increased muscle tone, exaggerated (hyperexcitable) tendon reflexes. Evidence: TAS. Frequency: Frequent (HP:0040282). (ORPHA:803)
- Dysarthria (HP:0001260): Dysarthric speech is a general description referring to a neurological speech disorder characterized by poor articulation. Depending on the involved neurological structures, dysarthria may be further classified as spastic, flaccid, ataxic, hyperkinetic and hypokinetic, or mixed. Evidence: TAS. Frequency: Frequent (HP:0040282). (ORPHA:803)
- Hyperreflexia (HP:0001347): Hyperreflexia is the presence of hyperactive stretch reflexes of the muscles. Evidence: TAS. Frequency: Frequent (HP:0040282). (ORPHA:803)
- Dysphonia (HP:0001618): Difficulty in speaking due to a physical disorder of the mouth, tongue, throat, or vocal cords. Associated with a known physical or neurological cause. Evidence: TAS. Frequency: Frequent (HP:0040282). (ORPHA:803)
- Weight loss (HP:0001824): Reduction of total body weight. Evidence: TAS. Frequency: Frequent (HP:0040282). (ORPHA:803)
- Dysphagia (HP:0002015): Difficulty in swallowing. Evidence: TAS. Frequency: Frequent (HP:0040282). (ORPHA:803)
- Dyspnea (HP:0002094): Difficult or labored breathing. Dyspnea is a subjective feeling only the patient can rate, e.g., on a Borg scale. Evidence: TAS. Frequency: Frequent (HP:0040282). (ORPHA:803)
- Drooling (HP:0002307): Habitual flow of saliva out of the mouth. Evidence: TAS. Frequency: Frequent (HP:0040282). (ORPHA:803)
- Fasciculations (HP:0002380): Fasciculations are observed as small, local, involuntary muscle contractions (twitching) visible under the skin. Fasciculations result from increased irritability of an axon (which in turn is often a manifestation of disease of a motor neuron). This leads to sporadic discharges of all the muscle fibers controlled by the axon in isolation from other motor units. Evidence: TAS. Frequency: Frequent (HP:0040282). (ORPHA:803)
- Respiratory failure (HP:0002878): A severe form of respiratory insufficiency characterized by inadequate gas exchange such that the levels of oxygen or carbon dioxide cannot be maintained within normal limits. Evidence: TAS. Frequency: Frequent (HP:0040282). (ORPHA:803)
- Skeletal muscle atrophy (HP:0003202): The presence of skeletal muscular atrophy (which is also known as amyotrophy). Evidence: TAS. Frequency: Frequent (HP:0040282). (ORPHA:803)
- Muscle spasm (HP:0003394): Sudden and involuntary contractions of one or more muscles. Evidence: TAS. Frequency: Frequent (HP:0040282). (ORPHA:803)
- Paralysis (HP:0003470): Paralysis of voluntary muscles means loss of contraction due to interruption of one or more motor pathways from the brain to the muscle fibers. Although the word paralysis is often used interchangeably to mean either complete or partial loss of muscle strength, it is preferable to use paralysis or plegia for complete or severe loss of muscle strength, and paresis for partial or slight loss. Motor paralysis results from deficits of the upper motor neurons (corticospinal, corticobulbar, or subcorticospinal). Motor paralysis is often accompanied by an impairment in the facility of movement. Evidence: TAS. Frequency: Frequent (HP:0040282). (ORPHA:803)
- Upper limb muscle weakness (HP:0003484): Weakness of the muscles of the arms. Evidence: TAS. Frequency: Frequent (HP:0040282). (ORPHA:803)
- Babinski sign (HP:0003487): Upturning of the big toe (and sometimes fanning of the other toes) in response to stimulation of the sole of the foot. If the Babinski sign is present it can indicate damage to the corticospinal tract. Evidence: TAS. Frequency: Frequent (HP:0040282). (ORPHA:803)
- Distal amyotrophy (HP:0003693): Muscular atrophy affecting muscles in the distal portions of the extremities. Evidence: TAS. Frequency: Frequent (HP:0040282). (ORPHA:803)
- Lower limb muscle weakness (HP:0007340): Weakness of the muscles of the legs. Evidence: TAS. Frequency: Frequent (HP:0040282). (ORPHA:803)
- Progressive distal muscular atrophy (HP:0008955): Progressive muscular atrophy affecting muscles in the distal portions of the extremities. Evidence: TAS. Frequency: Frequent (HP:0040282). (ORPHA:803)
- Fatigue (HP:0012378): A subjective feeling of tiredness characterized by a lack of energy and motivation. Evidence: TAS. Frequency: Frequent (HP:0040282). (ORPHA:803)
- Tongue atrophy (HP:0012473): Wasting of the tongue. Evidence: TAS. Frequency: Frequent (HP:0040282). (ORPHA:803)
- Pain (HP:0012531): An unpleasant sensory and emotional experience associated with actual or potential tissue damage, or described in terms of such damage. Evidence: TAS. Frequency: Frequent (HP:0040282). (ORPHA:803)
- Fatigable weakness of bulbar muscles (HP:0030192): A type of weakness of the bulbar muscles (muscles of the mouth and throat responsible for speech and swallowing) that occurs after a muscle group is used and lessens if the muscle group has some rest. That is, there is diminution of strength with repetitive muscle actions. Evidence: TAS. Frequency: Frequent (HP:0040282). (ORPHA:803)
- Fatigable weakness of swallowing muscles (HP:0030195): A type of weakness of the muscles involved in swallowing that occurs after a muscle group is used and lessens if the muscle group has some rest. That is, there is diminution of strength with repetitive muscle actions. Evidence: TAS. Frequency: Frequent (HP:0040282). (ORPHA:803)
- Fatigable weakness of respiratory muscles (HP:0030196): A type of weakness of the muscles involved in breathing (respiration) that occurs after a muscle group is used and lessens if the muscle group has some rest. That is, there is diminution of strength with repetitive muscle actions. Evidence: TAS. Frequency: Frequent (HP:0040282). (ORPHA:803)
- Abnormality on pulmonary function testing (HP:0030878): Any anomaly measure by pulmonary function testing, which includes spirometry, measures of diffusing capacity, and plethysmography. Evidence: TAS. Frequency: Frequent (HP:0040282). (ORPHA:803)
- Hoffmann sign (HP:0031993): A Hoffmann test is performed by flicking the fingernail of the long finger, from dorsal to volar, on each hand while the hand was supported by the examiner's hand. The test was done with the neck in the neutral position and then with the neck maximally forward flexed. Any flexion of the ipsilateral thumb and/or index finger was interpreted as a positive test. Evidence: TAS. Frequency: Frequent (HP:0040282). (ORPHA:803)
- Cognitive impairment (HP:0100543): Abnormal cognition is characterized by deficits in thinking, reasoning, or remembering. Evidence: TAS. Frequency: Frequent (HP:0040282). (ORPHA:803)
- Tongue fasciculations (HP:0001308): Fasciculations or fibrillation affecting the tongue muscle. Evidence: TAS. Frequency: Occasional (HP:0040283). (ORPHA:803)
- Frontotemporal dementia (HP:0002145): A dementia associated with degeneration of the frontotemporal lobe and clinically associated with personality and behavioral changes such as disinhibition, apathy, and lack of insight. The hallmark feature of frontotemporal dementia is the presentation with focal syndromes such as progressive language dysfunction, or aphasia, or behavioral changes characteristic of frontal lobe disorders. Evidence: TAS. Frequency: Occasional (HP:0040283). (ORPHA:803)
- Spastic paraparesis (HP:0002313): Partial loss of the ability to move the lower limbs accompanied by spasticity of the lower limbs. Evidence: TAS. Frequency: Occasional (HP:0040283). (ORPHA:803)
- Sleep disturbance (HP:0002360): An abnormal pattern in the quality, quantity, or characteristics of sleep. Evidence: TAS. Frequency: Occasional (HP:0040283). (ORPHA:803)
- Language impairment (HP:0002463): Language impairment is a deficit in comprehension or production of language that includes reduced vocabulary, limited sentence structure, or impairments in written or spoken communication. Language abilities are substantially and quantifiably below age expectations. Evidence: TAS. Frequency: Occasional (HP:0040283). (ORPHA:803)
- Steppage gait (HP:0003376): An abnormal gait pattern that arises from weakness of the pretibial and peroneal muscles due to a lower motor neuron lesion. Affected patients have footdrop and are unable to dorsiflex and evert the foot. The leg is lifted high on walking so that the toes clear the ground, and there may be a slapping noise when the foot strikes the ground again. Evidence: TAS. Frequency: Occasional (HP:0040283). (ORPHA:803)
- Cachexia (HP:0004326): Severe weight loss, wasting of muscle, loss of appetite, and general debility related to a chronic disease. Evidence: TAS. Frequency: Occasional (HP:0040283). (ORPHA:803)
- Foot dorsiflexor weakness (HP:0009027): Weakness of the muscles responsible for dorsiflexion of the foot, that is, of the movement of the toes towards the shin. The foot dorsiflexors include the tibialis anterior, the extensor hallucis longus, the extensor digitorum longus, and the peroneus tertius muscles. Evidence: TAS. Frequency: Occasional (HP:0040283). (ORPHA:803)
- Orthopnea (HP:0012764): A sensation of breathlessness in the recumbent position, relieved by sitting or standing. Evidence: TAS. Frequency: Occasional (HP:0040283). (ORPHA:803)
- Jaw hyperreflexia (HP:0033683): Increased intensity of muscle tendon reflexes in jaw. Evidence: TAS. Frequency: Occasional (HP:0040283). (ORPHA:803)
- Laryngospasm (HP:0025425): A spasm (involuntary contraction) of the vocal cords that can make it difficult to speak or breathe. Evidence: TAS. Frequency: Very rare (HP:0040284). (ORPHA:803)
These phenotypes are associated with the disease Amyotrophic lateral sclerosis (ORPHA:803).